Phenotypes associated with the disease Schuurs-Hoeijmakers syndrome (ORPHA:329224):
- Delayed speech and language development (HP:0000750): A degree of language development that is significantly below the norm for a child of a specified age. Evidence: TAS. Frequency: Very frequent (HP:0040281). (ORPHA:329224)
- Intellectual disability (HP:0001249): The term intellectual disability or intellectual developmental disorder is used to describe significantly sub-average intellectual and adaptive functioning based on clinical assessment and as measured by individually administered, appropriately normed, standardized and validated tests of intellectual functioning and adaptive behavior, with onset during the developmental period from infancy through adolescence. Evidence: TAS. Frequency: Very frequent (HP:0040281). (ORPHA:329224)
- Global developmental delay (HP:0001263): A delay in the achievement of motor or mental milestones in the domains of development of a child, including motor skills, speech and language, cognitive skills, and social and emotional skills. This term should only be used to describe children younger than five years of age. Evidence: TAS. Frequency: Very frequent (HP:0040281). (ORPHA:329224)
- Abnormal facial shape (HP:0001999): An abnormal morphology (form) of the face or its components. Evidence: TAS. Frequency: Very frequent (HP:0040281). (ORPHA:329224)
- Cryptorchidism (HP:0000028): Testis in inguinal canal. That is, absence of one or both testes from the scrotum owing to failure of the testis or testes to descend through the inguinal canal to the scrotum. Evidence: TAS. Frequency: Frequent (HP:0040282). (ORPHA:329224)
- Hypertelorism (HP:0000316): Interpupillary distance more than 2 SD above the mean (alternatively, the appearance of an increased interpupillary distance or widely spaced eyes). Evidence: TAS. Frequency: Frequent (HP:0040282). (ORPHA:329224)
- Low-set ears (HP:0000369): Upper insertion of the ear to the scalp below an imaginary horizontal line drawn between the inner canthi of the eye and extending posteriorly to the ear. Evidence: TAS. Frequency: Frequent (HP:0040282). (ORPHA:329224)
- Protruding ear (HP:0000411): Angle formed by the plane of the ear and the mastoid bone greater than the 97th centile for age (objective); or, outer edge of the helix more than 2 cm from the mastoid at the point of maximum distance (objective). Evidence: TAS. Frequency: Frequent (HP:0040282). (ORPHA:329224)
- Bulbous nose (HP:0000414): Increased volume and globular shape of the anteroinferior aspect of the nose. Evidence: TAS. Frequency: Frequent (HP:0040282). (ORPHA:329224)
- Downslanted palpebral fissures (HP:0000494): The palpebral fissure inclination is more than two standard deviations below the mean. Evidence: TAS. Frequency: Frequent (HP:0040282). (ORPHA:329224)
- Long eyelashes (HP:0000527): Mid upper eyelash length >10 mm or increased length of the eyelashes (subjective). Evidence: TAS. Frequency: Frequent (HP:0040282). (ORPHA:329224)
- Seizure (HP:0001250): A seizure is an intermittent abnormality of nervous system physiology characterized by a transient occurrence of signs and/or symptoms due to abnormal excessive or synchronous neuronal activity in the brain. Evidence: TAS. Frequency: Frequent (HP:0040282). (ORPHA:329224)
- Bilateral ptosis (HP:0001488). Evidence: TAS. Frequency: Frequent (HP:0040282). (ORPHA:329224)
- Failure to thrive (HP:0001508): Failure to thrive (FTT) refers to a child whose physical growth is substantially below the norm. Evidence: TAS. Frequency: Frequent (HP:0040282). (ORPHA:329224)
- Constipation (HP:0002019): Infrequent or difficult evacuation of feces. Evidence: TAS. Frequency: Frequent (HP:0040282). (ORPHA:329224)
- Highly arched eyebrow (HP:0002553): Increased height of the central portion of the eyebrow, forming a crescent, semicircular, or inverted U shape. Evidence: TAS. Frequency: Frequent (HP:0040282). (ORPHA:329224)
- Floppy infant (HP:0008947): Floppiness/hypotonia is defined as reduced resistance to passive movement of joints. Physical examination of floppy/hypotonic infants shows head lag, lack of shoulder and elbow muscle contraction on traction response, inability to tighten the shoulder girdle muscles (or slipping through) when held under the axillae, scarf sign (when the arm is pulled to the opposite side, the arm wraps around the neck with the elbow crossing midline), hyperdorsiflexion of the feet, easy apposition of the thumb against the forearm, feet touching the cheek with ease and without discomfort, frog leg position, and inverted U sign on ventral suspension (head, arms, and legs hanging down without elbow or knee flexion and the trunk rounded in a dome shape). Evidence: TAS. Frequency: Frequent (HP:0040282). (ORPHA:329224)
- Abnormal brain morphology (HP:0012443): A structural abnormality of the brain, which has as its parts the forebrain, midbrain, and hindbrain. Evidence: TAS. Frequency: Frequent (HP:0040282). (ORPHA:329224)
- Oral aversion (HP:0012523): Reluctance or refusal of a child to be breastfed or eat, manifested as gagging, vomiting, turning head away from food, or avoidance of sensation in or around the mouth (i.e. toothbrushing or face-washing). Evidence: TAS. Frequency: Frequent (HP:0040282). (ORPHA:329224)
- Abnormal temper tantrums (HP:0025160): Temper tantrums are brief episodes of extreme, unpleasant, and sometimes aggressive behaviors in response to frustration or anger, which are a normal part of development in toddlers. Temper tantrums that occur more frequently in a given time and/or are more severe in symptomatology and/or longer in duration and/or inappropriate for the given age compared to a temper tantrum that naturally occurs as a part of the developmental process are classified as abnormal temper tantrums. Evidence: TAS. Frequency: Frequent (HP:0040282). (ORPHA:329224)
- Inguinal hernia (HP:0000023): Protrusion of the contents of the abdominal cavity through the inguinal canal. Evidence: TAS. Frequency: Occasional (HP:0040283). (ORPHA:329224)
- Wide mouth (HP:0000154): Distance between the oral commissures more than 2 SD above the mean. Alternatively, an apparently increased width of the oral aperture (subjective). Evidence: TAS. Frequency: Occasional (HP:0040283). (ORPHA:329224)
- Thin upper lip vermilion (HP:0000219): Height of the vermilion of the upper lip in the midline more than 2 SD below the mean. Alternatively, an apparently reduced height of the vermilion of the upper lip in the frontal view (subjective). Evidence: TAS. Frequency: Occasional (HP:0040283). (ORPHA:329224)
- Microcephaly (HP:0000252): Head circumference below 2 standard deviations below the mean for age and gender. Evidence: TAS. Frequency: Occasional (HP:0040283). (ORPHA:329224)
- Low anterior hairline (HP:0000294): Distance between the hairline (trichion) and the glabella (the most prominent point on the frontal bone above the root of the nose), in the midline, more than two SD below the mean. Alternatively, an apparently decreased distance between the hairline and the glabella. Evidence: TAS. Frequency: Occasional (HP:0040283). (ORPHA:329224)
- Smooth philtrum (HP:0000319): Flat skin surface, with no ridge formation in the central region of the upper lip between the nasal base and upper vermilion border. Evidence: TAS. Frequency: Occasional (HP:0040283). (ORPHA:329224)
- Macrotia (HP:0000400): Median longitudinal ear length greater than two standard deviations above the mean and median ear width greater than two standard deviations above the mean (objective); or, apparent increase in length and width of the pinna (subjective). Evidence: TAS. Frequency: Occasional (HP:0040283). (ORPHA:329224)
- Coloboma (HP:0000589): A developmental defect characterized by a cleft of some portion of the eye or ocular adnexa. Evidence: TAS. Frequency: Occasional (HP:0040283). (ORPHA:329224)
- Synophrys (HP:0000664): Meeting of the medial eyebrows in the midline. Evidence: TAS. Frequency: Occasional (HP:0040283). (ORPHA:329224)
- Diastema (HP:0000699): Increased space between two adjacent teeth in the same dental arch. Evidence: TAS. Frequency: Occasional (HP:0040283). (ORPHA:329224)
- Autistic behavior (HP:0000729): Persistent deficits in social interaction and communication and interaction as well as a markedly restricted repertoire of activity and interest as well as repetitive patterns of behavior. Evidence: TAS. Frequency: Occasional (HP:0040283). (ORPHA:329224)
- Pectus excavatum (HP:0000767): A defect of the chest wall characterized by a depression of the sternum, giving the chest ("pectus") a caved-in ("excavatum") appearance. Evidence: TAS. Frequency: Occasional (HP:0040283). (ORPHA:329224)
- Single transverse palmar crease (HP:0000954): The distal and proximal transverse palmar creases are merged into a single transverse palmar crease. Evidence: TAS. Frequency: Occasional (HP:0040283). (ORPHA:329224)
- Single umbilical artery (HP:0001195): Single umbilical artery (SUA) is the absence of one of the two umbilical arteries surrounding the fetal bladder and in the fetal umbilical cord. Evidence: TAS. Frequency: Occasional (HP:0040283). (ORPHA:329224)
- Slender finger (HP:0001238): Fingers that are disproportionately narrow (reduced girth) for the hand/foot size or build of the individual. Evidence: TAS. Frequency: Occasional (HP:0040283). (ORPHA:329224)
- Dysarthria (HP:0001260): Dysarthric speech is a general description referring to a neurological speech disorder characterized by poor articulation. Depending on the involved neurological structures, dysarthria may be further classified as spastic, flaccid, ataxic, hyperkinetic and hypokinetic, or mixed. Evidence: TAS. Frequency: Occasional (HP:0040283). (ORPHA:329224)
- Cerebellar atrophy (HP:0001272): Cerebellar atrophy is defined as a cerebellum with initially normal structures, in a posterior fossa with normal size, which displays enlarged fissures (interfolial spaces) in comparison to the foliae secondary to loss of tissue. Cerebellar atrophy implies irreversible loss of tissue and result from an ongoing progressive disease until a final stage is reached or a single injury, e.g. an intoxication or infectious event. Evidence: TAS. Frequency: Occasional (HP:0040283). (ORPHA:329224)
- Cerebellar hypoplasia (HP:0001321): Cerebellar hypoplasia is a descriptive term implying a cerebellum with a reduced volume, but a normal shape and is stable over time. Evidence: TAS. Frequency: Occasional (HP:0040283). (ORPHA:329224)
- Absent speech (HP:0001344): Complete lack of development of speech and language abilities. Evidence: TAS. Frequency: Occasional (HP:0040283). (ORPHA:329224)
- Umbilical hernia (HP:0001537): Protrusion of abdominal contents through a defect in the abdominal wall musculature around the umbilicus. Skin and subcutaneous tissue overlie the defect. Evidence: TAS. Frequency: Occasional (HP:0040283). (ORPHA:329224)
- Ventricular septal defect (HP:0001629): A hole between the two bottom chambers (ventricles) of the heart. The defect is centered around the most superior aspect of the ventricular septum. Evidence: TAS. Frequency: Occasional (HP:0040283). (ORPHA:329224)
- Atrial septal defect (HP:0001631): Atrial septal defect (ASD) is a congenital abnormality of the interatrial septum that enables blood flow between the left and right atria via the interatrial septum. Evidence: TAS. Frequency: Occasional (HP:0040283). (ORPHA:329224)
- Patent ductus arteriosus (HP:0001643): In utero, the ductus arteriosus (DA) serves to divert ventricular output away from the lungs and toward the placenta by connecting the main pulmonary artery to the descending aorta. A patent ductus arteriosus (PDA) in the first 3 days of life is a physiologic shunt in healthy term and preterm newborn infants, and normally is substantially closed within about 24 hours after bith and completely closed after about three weeks. Failure of physiologcal closure is referred to a persistent or patent ductus arteriosus (PDA). Depending on the degree of left-to-right shunting, PDA can have clinical consequences. Evidence: TAS. Frequency: Occasional (HP:0040283). (ORPHA:329224)
- Bicuspid aortic valve (HP:0001647): The presence of an aortic valve with two instead of the normal three cusps (flaps). Bicuspid aortic valvue is a malformation of a commissure (small space between the attachment of each cusp to the aortic wall) and the adjacent parts of the two corresponding cusps forming a raphe (the fused area of the two underdeveloped cusps turning into a malformed commissure between both cusps; the raphe is a fibrous ridge that extends from the commissure to the free edge of the two underdeveloped, conjoint cusps). Evidence: TAS. Frequency: Occasional (HP:0040283). (ORPHA:329224)
- Patent foramen ovale (HP:0001655): Failure of the foramen ovale to seal postnatally, leaving a potential conduit between the left and right cardiac atria. Evidence: TAS. Frequency: Occasional (HP:0040283). (ORPHA:329224)
- Pes planus (HP:0001763): A foot where the longitudinal arch of the foot is in contact with the ground or floor when the individual is standing; or, in a patient lying supine, a foot where the arch is in contact with the surface of a flat board pressed against the sole of the foot by the examiner with a pressure similar to that expected from weight bearing; or, the height of the arch is reduced. Evidence: TAS. Frequency: Occasional (HP:0040283). (ORPHA:329224)
- Gastroesophageal reflux (HP:0002020): A condition in which the stomach contents leak backwards from the stomach into the esophagus through the lower esophageal sphincter. Evidence: TAS. Frequency: Occasional (HP:0040283). (ORPHA:329224)
- Unsteady gait (HP:0002317). Evidence: TAS. Frequency: Occasional (HP:0040283). (ORPHA:329224)
- Cavum septum pellucidum (HP:0002389): If the two laminae of the septum pellucidum are not fused then a fluid-filled space or cavum is present. The cavum septum pellucidum is present at birth but usually obliterates by the age of 3 to 6 months. It is up to 1cm in width and the walls are parallel. It is an enclosed space and is not part of the ventricular system or connected with the subarachnoid space. Evidence: TAS. Frequency: Occasional (HP:0040283). (ORPHA:329224)
- Scoliosis (HP:0002650): The presence of an abnormal lateral curvature of the spine. Evidence: TAS. Frequency: Occasional (HP:0040283). (ORPHA:329224)
- Downturned corners of mouth (HP:0002714): A morphological abnormality of the mouth in which the angle of the mouth is downturned. The oral commissures are positioned inferior to the midline labial fissure. Evidence: TAS. Frequency: Occasional (HP:0040283). (ORPHA:329224)
- Partial absence of cerebellar vermis (HP:0002951): Congenital absence of a part of the vermis of cerebellum. Evidence: TAS. Frequency: Occasional (HP:0040283). (ORPHA:329224)
- Clinodactyly of the 5th finger (HP:0004209): Clinodactyly refers to a bending or curvature of the fifth finger in the radial direction (i.e., towards the 4th finger). Evidence: TAS. Frequency: Occasional (HP:0040283). (ORPHA:329224)
- Decreased circulating complement C3 concentration (HP:0005421): Concentration of the complement component C3 in the blood circulation below the lower limit of normal. Evidence: TAS. Frequency: Occasional (HP:0040283). (ORPHA:329224)
- Wide intermamillary distance (HP:0006610): A larger than usual distance between the left and right nipple. Evidence: TAS. Frequency: Occasional (HP:0040283). (ORPHA:329224)
- Focal emotional seizure with laughing (HP:0010821): Focal emotional seizure with laughing (gelastic) is characterized by bursts of laughter or giggling, usually without appropriate related emotion of happiness, and described as 'mirthless'. Evidence: TAS. Frequency: Occasional (HP:0040283). (ORPHA:329224)
- Broad thumb (HP:0011304): Increased thumb width without increased dorso-ventral dimension. Evidence: TAS. Frequency: Occasional (HP:0040283). (ORPHA:329224)
- Abnormal renal morphology (HP:0012210): Any structural anomaly of the kidney. Evidence: TAS. Frequency: Occasional (HP:0040283). (ORPHA:329224)
- Nasogastric tube feeding (HP:0040288): The condition of inability to eat normally treated by placement of a thin tube through the nose into the stomach that is then used to carry food. Evidence: TAS. Frequency: Occasional (HP:0040283). (ORPHA:329224)